- Poor wound healing (HP:0001058): A reduced ability to heal cutaneous wounds. Evidence: TAS. Frequency: Very frequent (HP:0040281). (ORPHA:183707)
- Increased total leukocyte count (HP:0001974): An abnormal increase in the number of leukocytes in the blood. Evidence: TAS. Frequency: Very frequent (HP:0040281). (ORPHA:183707)
- Immunodeficiency (HP:0002721): Failure of the immune system to protect the body adequately from infection, due to the absence or insufficiency of some component process or substance. Evidence: TAS. Frequency: Very frequent (HP:0040281). (ORPHA:183707)
- Abnormal neutrophil physiology (HP:0011990): Any functional abnormality of neutrophils. Evidence: TAS. Frequency: Very frequent (HP:0040281). (ORPHA:183707)
These phenotypes are associated with the disease Infantile LAD-like disease due to RAC2 deficiency (ORPHA:183707).